- Dyslexia (HP:0010522): A learning disorder characterized primarily by difficulties in learning to read and spell. Dyslectic children also exhibit a tendency to read words from right to left and to confuse letters such as b and d whose orientation is important for their identification. Children with dyslexia appear to be impaired in phonemic skills (the ability to associate visual symbols with the sounds they represent). Evidence: IEA. (OMIM:600202)
- Autosomal dominant inheritance (HP:0000006): A mode of inheritance that is observed for traits related to a gene encoded on one of the autosomes (i.e., the human chromosomes 1-22) in which a trait manifests in heterozygotes. In the context of medical genetics, an autosomal dominant disorder is caused when a single copy of the mutant allele is present. Males and females are affected equally, and can both transmit the disorder with a risk of 50% for each child of inheriting the mutant allele. Evidence: TAS. (OMIM:600202)
These phenotypes are associated with the disease dyslexia, susceptibility to, 2 (OMIM:600202).